- Skeletal dysplasia (HP:0002652): A general term describing features characterized by abnormal development of bones and connective tissues. Evidence: IEA. (OMIM:146350)
- Short stature (HP:0004322): A height below that which is expected according to age and gender norms. Although there is no universally accepted definition of short stature, many refer to "short stature" as height more than 2 standard deviations below the mean for age and gender (or below the 3rd percentile for age and gender dependent norms). Evidence: IEA. (OMIM:146350)
- Rickets (HP:0002748): Rickets is divided into two major categories including calcipenic and phosphopenic. Hypophosphatemia is described as a common manifestation of both categories. Hypophosphatemic rickets is the most common type of rickets that is characterized by low levels of serum phosphate, resistance to ultraviolet radiation or vitamin D intake. There are several issues involved in hypophosphatemic rickets such as calcium, vitamin D, phosphorus deficiencies. Moreover, other disorder can be associated with its occurrence such as absorption defects due to pancreatic, intestinal, gastric, and renal disorders and hepatobiliary disease. Symptoms are usually seen in childhood and can be varied in severity. Severe forms may be linked to bowing of the legs, poor bone growth, and short stature as well as joint and bone pain. Hypophosphatemic rickets are associated with renal excretion of phosphate, hypophosphatemia, and mineral defects in bones. The familial type of the disease is the most common type of rickets. Evidence: IEA. Frequency: Occasional (HP:0040283). (OMIM:146350)
- Bowing of the legs (HP:0002979): A bending or abnormal curvature affecting a long bone of the leg. Evidence: IEA. (OMIM:146350)
- Osteomalacia (HP:0002749): Osteomalacia is a general term for bone weakness owing to a defect in mineralization of the protein framework known as osteoid. This defective mineralization is mainly caused by lack in vitamin D. Osteomalacia in children is known as rickets. Evidence: IEA. (OMIM:146350)
- Autosomal dominant inheritance (HP:0000006): A mode of inheritance that is observed for traits related to a gene encoded on one of the autosomes (i.e., the human chromosomes 1-22) in which a trait manifests in heterozygotes. In the context of medical genetics, an autosomal dominant disorder is caused when a single copy of the mutant allele is present. Males and females are affected equally, and can both transmit the disorder with a risk of 50% for each child of inheriting the mutant allele. Evidence: IEA. (OMIM:146350)
- Hypophosphatemia (HP:0002148): The concentration of phosphate ion in the blood circulation is below the lower limit of normal. Evidence: IEA. (OMIM:146350)
These phenotypes are associated with the disease hypophosphatemic bone disease (OMIM:146350).